Phenotypes associated with the disease sebocystomatosis (OMIM:184500):
- Natal tooth (HP:0000695): A tooth present at birth or erupting within the first month of life. Evidence: PCS. Frequency: 0/10. (PMID:9008238)
- Steatocystoma multiplex (HP:0012035): Multiple, localized or widespread, asymptomatic or inflammatory dermal cysts involving the pilosebaceous units. Lesions can appear anywhere on the body, but steatocystoma multiplex is more commonly involved with those areas of the skin with a high density of developed pilosebaceous units (e.g., the axilla, groin, neck, and proximal extremities). Evidence: PCS. Frequency: 10/10. (PMID:9008238)
- Autosomal dominant inheritance (HP:0000006): A mode of inheritance that is observed for traits related to a gene encoded on one of the autosomes (i.e., the human chromosomes 1-22) in which a trait manifests in heterozygotes. In the context of medical genetics, an autosomal dominant disorder is caused when a single copy of the mutant allele is present. Males and females are affected equally, and can both transmit the disorder with a risk of 50% for each child of inheriting the mutant allele. Evidence: PCS. (PMID:9008238)